Phenotypes associated with the disease Mounier-Kühn syndrome (ORPHA:3347):
- Abnormality of the respiratory system (HP:0002086): An abnormality of the respiratory system, which include the airways, lungs, and the respiratory muscles. Evidence: TAS. Frequency: Very frequent (HP:0040281). (ORPHA:3347)
- Pneumonia (HP:0002090): Inflammation of any part of the lung parenchyma. Evidence: TAS. Frequency: Very frequent (HP:0040281). (ORPHA:3347)
- Recurrent respiratory infections (HP:0002205): An increased susceptibility to respiratory infections as manifested by a history of recurrent respiratory infections. Evidence: TAS. Frequency: Very frequent (HP:0040281). (ORPHA:3347)
- Tracheal stenosis (HP:0002777). Evidence: TAS. Frequency: Very frequent (HP:0040281). (ORPHA:3347)
- Recurrent bronchopulmonary infections (HP:0006538): An increased susceptibility to bronchopulmonary infections as manifested by a history of recurrent bronchopulmonary infections. Evidence: TAS. Frequency: Very frequent (HP:0040281). (ORPHA:3347)
- Tracheobronchmegaly (HP:0010776): Marked widening of the trachea and major bronchi that may be predispose to chronic respiratory tract infection. Evidence: TAS. Frequency: Very frequent (HP:0040281). (ORPHA:3347)
- Bronchitis (HP:0012387): Inflammation of the large airways in the lung including any part of the bronchi from the primary bronchi to the tertiary bronchi. Evidence: TAS. Frequency: Very frequent (HP:0040281). (ORPHA:3347)